- Vertical supranuclear gaze palsy (HP:0000511): A supranuclear gaze palsy is an inability to look in a vertical direction as a result of cerebral impairment. There is a loss of the voluntary aspect of eye movements, but, as the brainstem is still intact, all the reflex conjugate eye movements are normal. Evidence: TAS. Frequency: Very frequent (HP:0040281). (ORPHA:646)
- Atypical behavior (HP:0000708): Atypical behavior is an abnormality in a person's actions that can be controlled or modulated by the will of the individual. While abnormal behaviors can be difficult to control, they are distinct from other abnormal actions that cannot be affected by the individual's will. Evidence: TAS. Frequency: Very frequent (HP:0040281). (ORPHA:646)
- Jaundice (HP:0000952): Yellow pigmentation of the skin due to bilirubin, which in turn is the result of increased bilirubin concentration in the bloodstream. Evidence: TAS. Frequency: Very frequent (HP:0040281). (ORPHA:646)
- Mental deterioration (HP:0001268): Loss of previously present mental abilities, generally in adults. Evidence: TAS. Frequency: Very frequent (HP:0040281). (ORPHA:646)
- Gait disturbance (HP:0001288): The term gait disturbance can refer to any disruption of the ability to walk. Evidence: TAS. Frequency: Very frequent (HP:0040281). (ORPHA:646)
- Abnormality of the liver (HP:0001392): An abnormality of the liver. Evidence: TAS. Frequency: Very frequent (HP:0040281). (ORPHA:646)
- Dysphagia (HP:0002015): Difficulty in swallowing. Evidence: TAS. Frequency: Very frequent (HP:0040281). (ORPHA:646)
- Hepatomegaly (HP:0002240): Abnormally increased size of the liver. Evidence: TAS. Frequency: Very frequent (HP:0040281). (ORPHA:646)
- Progressive neurologic deterioration (HP:0002344). Evidence: TAS. Frequency: Very frequent (HP:0040281). (ORPHA:646)
- Low cholesterol esterification rate (HP:0003349): A reduction in the rate of cholesterol esterification. Evidence: TAS. Frequency: Very frequent (HP:0040281). (ORPHA:646)
- Hearing impairment (HP:0000365): A decreased magnitude of the sensory perception of sound. Evidence: TAS. Frequency: Frequent (HP:0040282). (ORPHA:646)
- Seizure (HP:0001250): A seizure is an intermittent abnormality of nervous system physiology characterized by a transient occurrence of signs and/or symptoms due to abnormal excessive or synchronous neuronal activity in the brain. Evidence: TAS. Frequency: Frequent (HP:0040282). (ORPHA:646)
- Ataxia (HP:0001251): Ataxia refers to impaired coordination of voluntary muscle movement. Cerebellar ataxia refers to ataxia due to dysfunction of the cerebellum. This causes a variety of elementary neurological deficits including asynergy (lack of coordination between muscles, limbs and joints), dysmetria (lack of ability to judge distances that can lead to under- or overshoot in grasping movements), and dysdiadochokinesia (inability to perform rapid movements requiring antagonizing muscle groups to be switched on and off repeatedly). Evidence: TAS. Frequency: Frequent (HP:0040282). (ORPHA:646)
- Dysarthria (HP:0001260): Dysarthric speech is a general description referring to a neurological speech disorder characterized by poor articulation. Depending on the involved neurological structures, dysarthria may be further classified as spastic, flaccid, ataxic, hyperkinetic and hypokinetic, or mixed. Evidence: TAS. Frequency: Frequent (HP:0040282). (ORPHA:646)
- Dystonia (HP:0001332): An abnormally increased muscular tone that causes fixed abnormal postures. There is a slow, intermittent twisting motion that leads to exaggerated turning and posture of the extremities and trunk. Evidence: TAS. Frequency: Frequent (HP:0040282). (ORPHA:646)
- Dysphonia (HP:0001618): Difficulty in speaking due to a physical disorder of the mouth, tongue, throat, or vocal cords. Associated with a known physical or neurological cause. Evidence: TAS. Frequency: Frequent (HP:0040282). (ORPHA:646)
- Splenomegaly (HP:0001744): Abnormal increased size of the spleen. Evidence: TAS. Frequency: Frequent (HP:0040282). (ORPHA:646)
- Abnormal speech pattern (HP:0002167): An abnormality in the sound (volume) or cadence (rate) of speech. Evidence: TAS. Frequency: Frequent (HP:0040282). (ORPHA:646)
- Limb dystonia (HP:0002451): A type of dystonia (abnormally increased muscular tone causing fixed abnormal postures) that affects muscles of the limbs. Evidence: TAS. Frequency: Frequent (HP:0040282). (ORPHA:646)
- Axial dystonia (HP:0002530): A type of dystonia that affects the midline muscles, i.e., the chest, abdominal, and back muscles. Evidence: TAS. Frequency: Frequent (HP:0040282). (ORPHA:646)
- Foam cells (HP:0003651): The presence of foam cells, a type of macrophage that localizes to fatty deposits on blood vessel walls, where they ingest low-density lipoproteins and become laden with lipids, giving them a foamy appearance. Evidence: TAS. Frequency: Frequent (HP:0040282). (ORPHA:646)
- Bone-marrow foam cells (HP:0004333): The presence of foam cells in the bone marrow, generally demonstrated by bone-marrow aspiration or biopsy. Foam cells have a vacuolated appearance due to the presence of complex lipid deposits, giving them a foamy or soap-suds appearance. Evidence: TAS. Frequency: Frequent (HP:0040282). (ORPHA:646)
- Progressive gait ataxia (HP:0007240): A type of gait ataxia displaying progression of clinical severity. Evidence: TAS. Frequency: Frequent (HP:0040282). (ORPHA:646)
- Aplasia/Hypoplasia of the abdominal wall musculature (HP:0010318): Absence or underdevelopment of the abdominal musculature. Evidence: TAS. Frequency: Frequent (HP:0040282). (ORPHA:646)
- Abnormality of mental function (HP:0011446): Cognitive, psychiatric, or memory anomaly. Evidence: TAS. Frequency: Frequent (HP:0040282). (ORPHA:646)
- Feeding difficulties (HP:0011968): Impaired ability to eat related to problems gathering food and getting ready to suck, chew, or swallow it. Evidence: TAS. Frequency: Frequent (HP:0040282). (ORPHA:646)
- Abnormality of movement (HP:0100022): An abnormality of movement with a neurological basis characterized by changes in coordination and speed of voluntary movements. Evidence: TAS. Frequency: Frequent (HP:0040282). (ORPHA:646)
- Cognitive impairment (HP:0100543): Abnormal cognition is characterized by deficits in thinking, reasoning, or remembering. Evidence: TAS. Frequency: Frequent (HP:0040282). (ORPHA:646)
- Psychosis (HP:0000709): A condition characterized by changes in personality and thought patterns, often accompanied by hallucinations and delusional beliefs, is known as psychosis. Evidence: TAS. Frequency: Occasional (HP:0040283). (ORPHA:646)
- Depression (HP:0000716): Frequently experiencing feelings of being down, miserable, and/or hopeless; struggling to recover from these moods; having a pessimistic outlook on the future; feeling a pervasive sense of shame; having a low self-worth; experiencing thoughts of suicide and engaging in suicidal behavior. Evidence: TAS. Frequency: Occasional (HP:0040283). (ORPHA:646)
- Aggressive behavior (HP:0000718): Behavior or an act aimed at harming a person, animal, or physical property (e.g., acts of physical violence; shouting, swearing, and using harsh language; slashing someone's tires). Evidence: TAS. Frequency: Occasional (HP:0040283). (ORPHA:646)
- Compulsive behaviors (HP:0000722): Behavior that consists of repetitive acts, characterized by the feeling that one "has to" perform them, while being aware that these acts are not in line with one's overall goal. Evidence: TAS. Frequency: Occasional (HP:0040283). (ORPHA:646)
- Dementia (HP:0000726): A loss of global cognitive ability of sufficient amount to interfere with normal social or occupational function. Dementia represents a loss of previously present cognitive abilities, generally in adults, and can affect memory, thinking, language, judgment, and behavior. Evidence: TAS. Frequency: Occasional (HP:0040283). (ORPHA:646)
- Disinhibition (HP:0000734): Reduced ability to control, or a failure to resist a temptation, urge, or impulse. Examples include disregard for social conventions, general impulsivity, and poor risk assessment. Evidence: TAS. Frequency: Occasional (HP:0040283). (ORPHA:646)
- Apathy (HP:0000741): Apathy is a quantitative reduction of interest, motivation and the initiation and persistence of goal-directed behavior, where often the accompanying emotions, thoughts, and social interactions are also diminished. The individual is typically non-reactive to provocations, positive or negative, and appears to not care. Distinguished from lethargy which involves lack of physical or mental energy. Evidence: TAS. Frequency: Occasional (HP:0040283). (ORPHA:646)
- Low frustration tolerance (HP:0000744): The feeling of frustration can be defined as an emotional reaction that occurs when a desired goal is not achieved. Frustration intolerance is defined as an age-inappropriate response to frustration, characterized by crying or temper tantrums in children, or aggressive or other maladaptive behaviors. Evidence: TAS. Frequency: Occasional (HP:0040283). (ORPHA:646)
- Delayed speech and language development (HP:0000750): A degree of language development that is significantly below the norm for a child of a specified age. Evidence: TAS. Frequency: Occasional (HP:0040283). (ORPHA:646)
- Intellectual disability (HP:0001249): The term intellectual disability or intellectual developmental disorder is used to describe significantly sub-average intellectual and adaptive functioning based on clinical assessment and as measured by individually administered, appropriately normed, standardized and validated tests of intellectual functioning and adaptive behavior, with onset during the developmental period from infancy through adolescence. Evidence: TAS. Frequency: Occasional (HP:0040283). (ORPHA:646)
- Hypotonia (HP:0001252): Hypotonia is an abnormally low muscle tone (the amount of tension or resistance to movement in a muscle). Even when relaxed, muscles have a continuous and passive partial contraction which provides some resistance to passive stretching. Hypotonia thus manifests as diminished resistance to passive stretching. Hypotonia is not the same as muscle weakness, although the two conditions can co-exist. Evidence: TAS. Frequency: Occasional (HP:0040283). (ORPHA:646)
- Global developmental delay (HP:0001263): A delay in the achievement of motor or mental milestones in the domains of development of a child, including motor skills, speech and language, cognitive skills, and social and emotional skills. This term should only be used to describe children younger than five years of age. Evidence: TAS. Frequency: Occasional (HP:0040283). (ORPHA:646)
- Specific learning disability (HP:0001328): Impairment of certain skills such as reading or writing, coordination, self-control, or attention that interfere with the ability to learn. The impairment is not related to a global deficiency of intelligence. Evidence: TAS. Frequency: Occasional (HP:0040283). (ORPHA:646)
- Myoclonus (HP:0001336): Very brief, involuntary random muscular contractions occurring at rest, in response to sensory stimuli, or accompanying voluntary movements. Evidence: TAS. Frequency: Occasional (HP:0040283). (ORPHA:646)
- Tremor (HP:0001337): An unintentional, oscillating to-and-fro muscle movement about a joint axis. Evidence: TAS. Frequency: Occasional (HP:0040283). (ORPHA:646)
- Hepatosplenomegaly (HP:0001433): Simultaneous enlargement of the liver and spleen. Evidence: TAS. Frequency: Occasional (HP:0040283). (ORPHA:646)
- Cerebral atrophy (HP:0002059): Atrophy (wasting, decrease in size of cells or tissue) affecting the cerebrum. Evidence: TAS. Frequency: Occasional (HP:0040283). (ORPHA:646)
- Lower limb spasticity (HP:0002061): Spasticity (velocity-dependent increase in tonic stretch reflexes with increased muscle tone and hyperexcitable tendon reflexes) in the muscles of the lower limbs, hips, and pelvis. Evidence: TAS. Frequency: Occasional (HP:0040283). (ORPHA:646)
- Chorea (HP:0002072): Chorea (Greek for 'dance') refers to widespread arrhythmic involuntary movements of a forcible, jerky and restless fashion. It is a random-appearing sequence of one or more discrete involuntary movements or movement fragments. Movements appear random because of variability in timing, duration or location. Each movement may have a distinct start and end. However, movements may be strung together and thus may appear to flow randomly from one muscle group to another. Chorea can involve the trunk, neck, face, tongue, and extremities. Evidence: TAS. Frequency: Occasional (HP:0040283). (ORPHA:646)
- Hypoplasia of the corpus callosum (HP:0002079): Underdevelopment of the corpus callosum. Evidence: TAS. Frequency: Occasional (HP:0040283). (ORPHA:646)
- Intention tremor (HP:0002080): A type of kinetic tremor that occurs during target directed movement is called intention tremor. That is, an oscillatory cerebellar ataxia that tends to be absent when the limbs are inactive and during the first part of voluntary movement but worsening as the movement continues and greater precision is required (e.g., in touching a target such as the patient's nose or a physician's finger). Evidence: TAS. Frequency: Occasional (HP:0040283). (ORPHA:646)
- Generalized-onset seizure (HP:0002197): A generalized-onset seizure is a type of seizure originating at some point within, and rapidly engaging, bilaterally distributed networks. The networks may include cortical and subcortical structures but not necessarily the entire cortex. Evidence: TAS. Frequency: Occasional (HP:0040283). (ORPHA:646)
- Clumsiness (HP:0002312): Lack of physical coordination resulting in an abnormal tendency to drop items or bump into objects. Evidence: TAS. Frequency: Occasional (HP:0040283). (ORPHA:646)
- Frequent falls (HP:0002359). Evidence: TAS. Frequency: Occasional (HP:0040283). (ORPHA:646)
- Sleep disturbance (HP:0002360): An abnormal pattern in the quality, quantity, or characteristics of sleep. Evidence: TAS. Frequency: Occasional (HP:0040283). (ORPHA:646)
- Visual hallucination (HP:0002367): Visual perception in the absence of a visual stimulus. Evidence: TAS. Frequency: Occasional (HP:0040283). (ORPHA:646)
- Developmental regression (HP:0002376): Loss of developmental skills, as manifested by loss of developmental milestones. Evidence: TAS. Frequency: Occasional (HP:0040283). (ORPHA:646)
- Leukodystrophy (HP:0002415): Leukodystrophy refers to deterioration of white matter of the brain resulting from degeneration of myelin sheaths in the CNS. Their basic defect is directly related to the synthesis and maintenance of myelin membranes. Symmetric white matter involvement at MRI is a typical finding in patients with leukodystrophies. Evidence: TAS. Frequency: Occasional (HP:0040283). (ORPHA:646)
- Upper motor neuron dysfunction (HP:0002493): A functional anomaly of the upper motor neuron. The upper motor neurons are neurons of the primary motor cortex which project to the brainstem and spinal chord via the corticonuclear, corticobulbar and corticospinal (pyramidal) tracts. They are involved in control of voluntary movements. Dysfunction leads to weakness, impairment of fine motor movements, spasticity, hyperreflexia and abnormal pyramidal signs. Evidence: TAS. Frequency: Occasional (HP:0040283). (ORPHA:646)
- Cataplexy (HP:0002524): A sudden and transient episode of bilateral loss of muscle tone, often triggered by emotions. Evidence: TAS. Frequency: Occasional (HP:0040283). (ORPHA:646)
- Cerebellar vermis atrophy (HP:0006855): Wasting (atrophy) of the vermis of cerebellum. Evidence: TAS. Frequency: Occasional (HP:0040283). (ORPHA:646)
- Abnormal pyramidal sign (HP:0007256): Functional neurological abnormalities related to dysfunction of the pyramidal tract. Evidence: TAS. Frequency: Occasional (HP:0040283). (ORPHA:646)
- Focal-onset seizure (HP:0007359): A focal-onset seizure is a type of seizure originating within networks limited to one hemisphere. They may be discretely localized or more widely distributed, and may originate in subcortical structures. Evidence: TAS. Frequency: Occasional (HP:0040283). (ORPHA:646)
- Auditory hallucination (HP:0008765): Perception of sounds without auditory stimulus. Evidence: TAS. Frequency: Occasional (HP:0040283). (ORPHA:646)
- Speech apraxia (HP:0011098): A type of apraxia that is characterized by difficulty or inability to execute speech movements because of problems with coordination and motor problems, leading to incorrect articulation. An increase of errors with increasing word and phrase length may occur. Evidence: TAS. Frequency: Occasional (HP:0040283). (ORPHA:646)
- Abnormal CNS myelination (HP:0011400): An abnormality of myelination of nerves in the central nervous system. Evidence: TAS. Frequency: Occasional (HP:0040283). (ORPHA:646)
- Gastrostomy tube feeding in infancy (HP:0011471): Feeding problem necessitating gastrostomy tube feeding. Evidence: TAS. Frequency: Occasional (HP:0040283). (ORPHA:646)
- Abnormal social behavior (HP:0012433): An abnormality of actions or reactions of a person exhibited during social interactions with other individuals. Evidence: TAS. Frequency: Occasional (HP:0040283). (ORPHA:646)
- Cataplexy (HP:0002524): A sudden and transient episode of bilateral loss of muscle tone, often triggered by emotions. Evidence: TAS. Frequency: Occasional (HP:0040283). (ORPHA:646)
- Schizophrenia (HP:0100753): A mental disorder characterized by a disintegration of thought processes and emotional responsiveness. It most commonly manifests as auditory hallucinations, paranoid or bizarre delusions, or disorganized speech and thinking. It is accompanied by significant social or occupational dysfunction. The onset of symptoms typically occurs in young adulthood, with a global lifetime prevalence of about 1%. This term is not a helpful parent term to describe abnormal experiences. Evidence: TAS. Frequency: Occasional (HP:0040283). (ORPHA:646)
- Hepatic failure (HP:0001399). Evidence: TAS. Frequency: Very rare (HP:0040284). (ORPHA:646)
- Ascites (HP:0001541): Accumulation of fluid in the peritoneal cavity (between the layers of the peritoneum that lines the abdomen). Evidence: TAS. Frequency: Very rare (HP:0040284). (ORPHA:646)
- Hydrops fetalis (HP:0001789): The abnormal accumulation of fluid in two or more fetal compartments, including ascites, pleural effusion, pericardial effusion, and skin edema. Evidence: TAS. Frequency: Very rare (HP:0040284). (ORPHA:646)
- Fetal ascites (HP:0001791): Accumulation of fluid in the peritoneal cavity during the fetal period. Evidence: TAS. Frequency: Very rare (HP:0040284). (ORPHA:646)
- Abnormal lung morphology (HP:0002088): Any structural anomaly of the lung. Evidence: TAS. Frequency: Very rare (HP:0040284). (ORPHA:646)
- Respiratory insufficiency (HP:0002093). Evidence: TAS. Frequency: Very rare (HP:0040284). (ORPHA:646)
- Pulmonary infiltrates (HP:0002113). Evidence: TAS. Frequency: Very rare (HP:0040284). (ORPHA:646)
- Status epilepticus (HP:0002133): Status epilepticus is a type of prolonged seizure resulting either from the failure of the mechanisms responsible for seizure termination or from the initiation of mechanisms which lead to abnormally prolonged seizures (after time point t1). It is a condition that can have long-term consequences (after time point t2), including neuronal death, neuronal injury, and alteration of neuronal networks, depending on the type and duration of seizures. Evidence: TAS. Frequency: Very rare (HP:0040284). (ORPHA:646)
- Respiratory failure (HP:0002878): A severe form of respiratory insufficiency characterized by inadequate gas exchange such that the levels of oxygen or carbon dioxide cannot be maintained within normal limits. Evidence: TAS. Frequency: Very rare (HP:0040284). (ORPHA:646)
- Frontal cortical atrophy (HP:0006913): Atrophy of the frontal cortex. Evidence: TAS. Frequency: Very rare (HP:0040284). (ORPHA:646)
- Demyelinating peripheral neuropathy (HP:0007108): Demyelinating neuropathy is characterized by slow nerve conduction velocities with reduced amplitudes of sensory/motor nerve conduction and prolonged distal latencies. Evidence: TAS. Frequency: Very rare (HP:0040284). (ORPHA:646)
- Bipolar affective disorder (HP:0007302): Bipolar disorder is an illness of mood characterized by alternating episodes of elevated and depressed moods, which are interspersed with euthymic periods. Evidence: TAS. Frequency: Very rare (HP:0040284). (ORPHA:646)
- Aspiration pneumonia (HP:0011951): Pneumonia due to the aspiration (breathing in) of food, liquid, or gastric contents into the upper respiratory tract. Evidence: TAS. Frequency: Very rare (HP:0040284). (ORPHA:646)
These phenotypes are associated with the disease Niemann-Pick disease type C (ORPHA:646).